- Cryptorchidism (HP:0000028): Testis in inguinal canal. That is, absence of one or both testes from the scrotum owing to failure of the testis or testes to descend through the inguinal canal to the scrotum. Evidence: TAS. Frequency: Frequent (HP:0040282). (ORPHA:363611)
- Abnormality of the dentition (HP:0000164): Any abnormality of the teeth. Evidence: TAS. Frequency: Frequent (HP:0040282). (ORPHA:363611)
- Thin upper lip vermilion (HP:0000219): Height of the vermilion of the upper lip in the midline more than 2 SD below the mean. Alternatively, an apparently reduced height of the vermilion of the upper lip in the frontal view (subjective). Evidence: TAS. Frequency: Frequent (HP:0040282). (ORPHA:363611)
- Thin vermilion border (HP:0000233): Height of the vermilion of the medial part of the lip more than 2 SD below the mean, or apparently reduced height of the vermilion of the lip in the frontal view. The vermilion is the red part of the lips (and confusingly, the vermilion itself is also often referred to as being equivalent the lips). Evidence: TAS. Frequency: Frequent (HP:0040282). (ORPHA:363611)
- Microcephaly (HP:0000252): Head circumference below 2 standard deviations below the mean for age and gender. Evidence: TAS. Frequency: Frequent (HP:0040282). (ORPHA:363611)
- Strabismus (HP:0000486): A misalignment of the eyes so that the visual axes deviate from bifoveal fixation. The classification of strabismus may be based on a number of features including the relative position of the eyes, whether the deviation is latent or manifest, intermittent or constant, concomitant or otherwise and according to the age of onset and the relevance of any associated refractive error. Evidence: TAS. Frequency: Frequent (HP:0040282). (ORPHA:363611)
- Long eyelashes (HP:0000527): Mid upper eyelash length >10 mm or increased length of the eyelashes (subjective). Evidence: TAS. Frequency: Frequent (HP:0040282). (ORPHA:363611)
- Hypermetropia (HP:0000540): An abnormality of refraction characterized by the ability to see objects in the distance clearly, while objects nearby appear blurry. Evidence: TAS. Frequency: Frequent (HP:0040282). (ORPHA:363611)
- Thick eyebrow (HP:0000574): Increased density/number and/or increased diameter of eyebrow hairs. Evidence: TAS. Frequency: Frequent (HP:0040282). (ORPHA:363611)
- Macrodontia of permanent maxillary central incisor (HP:0000675): Increased size of the maxillary central secondary incisor tooth. Evidence: TAS. Frequency: Frequent (HP:0040282). (ORPHA:363611)
- Atypical behavior (HP:0000708): Atypical behavior is an abnormality in a person's actions that can be controlled or modulated by the will of the individual. While abnormal behaviors can be difficult to control, they are distinct from other abnormal actions that cannot be affected by the individual's will. Evidence: TAS. Frequency: Frequent (HP:0040282). (ORPHA:363611)
- Autistic behavior (HP:0000729): Persistent deficits in social interaction and communication and interaction as well as a markedly restricted repertoire of activity and interest as well as repetitive patterns of behavior. Evidence: TAS. Frequency: Frequent (HP:0040282). (ORPHA:363611)
- Delayed speech and language development (HP:0000750): A degree of language development that is significantly below the norm for a child of a specified age. Evidence: TAS. Frequency: Frequent (HP:0040282). (ORPHA:363611)
- Single transverse palmar crease (HP:0000954): The distal and proximal transverse palmar creases are merged into a single transverse palmar crease. Evidence: TAS. Frequency: Frequent (HP:0040282). (ORPHA:363611)
- Intellectual disability (HP:0001249): The term intellectual disability or intellectual developmental disorder is used to describe significantly sub-average intellectual and adaptive functioning based on clinical assessment and as measured by individually administered, appropriately normed, standardized and validated tests of intellectual functioning and adaptive behavior, with onset during the developmental period from infancy through adolescence. Evidence: TAS. Frequency: Frequent (HP:0040282). (ORPHA:363611)
- Hypotonia (HP:0001252): Hypotonia is an abnormally low muscle tone (the amount of tension or resistance to movement in a muscle). Even when relaxed, muscles have a continuous and passive partial contraction which provides some resistance to passive stretching. Hypotonia thus manifests as diminished resistance to passive stretching. Hypotonia is not the same as muscle weakness, although the two conditions can co-exist. Evidence: TAS. Frequency: Frequent (HP:0040282). (ORPHA:363611)
- Failure to thrive (HP:0001508): Failure to thrive (FTT) refers to a child whose physical growth is substantially below the norm. Evidence: TAS. Frequency: Frequent (HP:0040282). (ORPHA:363611)
- Small for gestational age (HP:0001518): Smaller than normal size according to sex and gestational age related norms, defined as a weight below the 10th percentile for the gestational age. Evidence: TAS. Frequency: Frequent (HP:0040282). (ORPHA:363611)
- Atrial septal defect (HP:0001631): Atrial septal defect (ASD) is a congenital abnormality of the interatrial septum that enables blood flow between the left and right atria via the interatrial septum. Evidence: TAS. Frequency: Frequent (HP:0040282). (ORPHA:363611)
- Patent ductus arteriosus (HP:0001643): In utero, the ductus arteriosus (DA) serves to divert ventricular output away from the lungs and toward the placenta by connecting the main pulmonary artery to the descending aorta. A patent ductus arteriosus (PDA) in the first 3 days of life is a physiologic shunt in healthy term and preterm newborn infants, and normally is substantially closed within about 24 hours after bith and completely closed after about three weeks. Failure of physiologcal closure is referred to a persistent or patent ductus arteriosus (PDA). Depending on the degree of left-to-right shunting, PDA can have clinical consequences. Evidence: TAS. Frequency: Frequent (HP:0040282). (ORPHA:363611)
- Sandal gap (HP:0001852): A widely spaced gap between the first toe (the great toe) and the second toe. Evidence: TAS. Frequency: Frequent (HP:0040282). (ORPHA:363611)
- Abnormal facial shape (HP:0001999): An abnormal morphology (form) of the face or its components. Evidence: TAS. Frequency: Frequent (HP:0040282). (ORPHA:363611)
- Ventriculomegaly (HP:0002119): An increase in size of the ventricular system of the brain. Evidence: TAS. Frequency: Frequent (HP:0040282). (ORPHA:363611)
- Recurrent infections (HP:0002719): Increased susceptibility to infections as manifested by repeated bouts of infection. Evidence: TAS. Frequency: Frequent (HP:0040282). (ORPHA:363611)
- Clinodactyly of the 5th finger (HP:0004209): Clinodactyly refers to a bending or curvature of the fifth finger in the radial direction (i.e., towards the 4th finger). Evidence: TAS. Frequency: Frequent (HP:0040282). (ORPHA:363611)
- Broad hallux phalanx (HP:0010059): An increase in width in one or more phalanges of the big toe. Evidence: TAS. Frequency: Frequent (HP:0040282). (ORPHA:363611)
- Feeding difficulties (HP:0011968): Impaired ability to eat related to problems gathering food and getting ready to suck, chew, or swallow it. Evidence: TAS. Frequency: Frequent (HP:0040282). (ORPHA:363611)
- Neurodevelopmental delay (HP:0012758): Neurodevelopmental delay (NDD) refers to delays in the maturation of the brain and central nervous system; infants and young children with NDD may experience delays in the development of one or more skills including gross motor abilities, fine-motor coordination, language abilities and ability to solve increasingly complex problems. Evidence: TAS. Frequency: Frequent (HP:0040282). (ORPHA:363611)
- Inguinal hernia (HP:0000023): Protrusion of the contents of the abdominal cavity through the inguinal canal. Evidence: TAS. Frequency: Occasional (HP:0040283). (ORPHA:363611)
- Hypoplastic labia majora (HP:0000059): Undergrowth of the outer labia. Evidence: TAS. Frequency: Occasional (HP:0040283). (ORPHA:363611)
- Narrow mouth (HP:0000160): Distance between the commissures of the mouth more than 2 SD below the mean. Alternatively, an apparently decreased width of the oral aperture (subjective). Evidence: TAS. Frequency: Occasional (HP:0040283). (ORPHA:363611)
- Cleft palate (HP:0000175): Cleft palate is a developmental defect of the palate resulting from a failure of fusion of the palatine processes and manifesting as a separation of the roof of the mouth (soft and hard palate). Evidence: TAS. Frequency: Occasional (HP:0040283). (ORPHA:363611)
- Epicanthus (HP:0000286): A fold of skin starting above the medial aspect of the upper eyelid and arching downward to cover, pass in front of and lateral to the medial canthus. Evidence: TAS. Frequency: Occasional (HP:0040283). (ORPHA:363611)
- Hypertelorism (HP:0000316): Interpupillary distance more than 2 SD above the mean (alternatively, the appearance of an increased interpupillary distance or widely spaced eyes). Evidence: TAS. Frequency: Occasional (HP:0040283). (ORPHA:363611)
- Short philtrum (HP:0000322): Distance between nasal base and midline upper lip vermilion border more than 2 SD below the mean. Alternatively, an apparently decreased distance between nasal base and midline upper lip vermilion border. Evidence: TAS. Frequency: Occasional (HP:0040283). (ORPHA:363611)
- Narrow forehead (HP:0000341): Width of the forehead or distance between the frontotemporales is more than two standard deviations below the mean (objective); or apparently narrow intertemporal region (subjective). Evidence: TAS. Frequency: Occasional (HP:0040283). (ORPHA:363611)
- Long philtrum (HP:0000343): Distance between nasal base and midline upper lip vermilion border more than 2 SD above the mean. Alternatively, an apparently increased distance between nasal base and midline upper lip vermilion border. Evidence: TAS. Frequency: Occasional (HP:0040283). (ORPHA:363611)
- High forehead (HP:0000348): An abnormally increased height of the forehead. Evidence: TAS. Frequency: Occasional (HP:0040283). (ORPHA:363611)
- Posteriorly rotated ears (HP:0000358): A type of abnormal location of the ears in which the position of the ears is characterized by posterior rotation (the superior part of the ears is rotated towards the back of the head, and the inferior part of the ears towards the front). Evidence: TAS. Frequency: Occasional (HP:0040283). (ORPHA:363611)
- Cupped ear (HP:0000378): Laterally protruding ear that lacks antihelical folding (including absence of inferior and superior crura). Evidence: TAS. Frequency: Occasional (HP:0040283). (ORPHA:363611)
- Broad nasal tip (HP:0000455): Increase in width of the nasal tip. Evidence: TAS. Frequency: Occasional (HP:0040283). (ORPHA:363611)
- Anteverted nares (HP:0000463): Anteriorly-facing nostrils viewed with the head in the Frankfurt horizontal and the eyes of the observer level with the eyes of the subject. This gives the appearance of an upturned nose (upturned nasal tip). Evidence: TAS. Frequency: Occasional (HP:0040283). (ORPHA:363611)
- Microcornea (HP:0000482): A congenital abnormality of the cornea in which the cornea and the anterior segment of the eye are smaller than normal. The horizontal diameter of the cornea does not reach 10 mm even in adulthood. Evidence: TAS. Frequency: Occasional (HP:0040283). (ORPHA:363611)
- Deeply set eye (HP:0000490): An eye that is more deeply recessed into the plane of the face than is typical. Evidence: TAS. Frequency: Occasional (HP:0040283). (ORPHA:363611)
- Synophrys (HP:0000664): Meeting of the medial eyebrows in the midline. Evidence: TAS. Frequency: Occasional (HP:0040283). (ORPHA:363611)
- Microdontia (HP:0000691): Decreased size of the teeth, which can be defined as a mesiodistal tooth diameter (width) more than 2 SD below mean. Alternatively, an apparently decreased maximum width of tooth. Evidence: TAS. Frequency: Occasional (HP:0040283). (ORPHA:363611)
- Osteopenia (HP:0000938): Osteopenia is a term to define bone density that is not normal but also not as low as osteoporosis. By definition from the World Health Organization osteopenia is defined by bone densitometry as a T score -1 to -2.5. Evidence: TAS. Frequency: Occasional (HP:0040283). (ORPHA:363611)
- Sacral dimple (HP:0000960): A cutaneous indentation resulting from tethering of the skin to underlying structures (bone) of the intergluteal cleft. Evidence: TAS. Frequency: Occasional (HP:0040283). (ORPHA:363611)
- Hypertrichosis (HP:0000998): Hypertrichosis is increased hair growth that is abnormal in quantity or location. Evidence: TAS. Frequency: Occasional (HP:0040283). (ORPHA:363611)
- Prominent fingertip pads (HP:0001212): A soft tissue prominence of the ventral aspects of the fingertips. The term "persistent fetal fingertip pads" is often used as a synonym, but should better not be used because it implies knowledge of history of the patient which often does not exist. Evidence: TAS. Frequency: Occasional (HP:0040283). (ORPHA:363611)
- Craniosynostosis (HP:0001363): Craniosynostosis refers to the premature closure of the cranial sutures. Primary craniosynostosis refers to the closure of one or more sutures due to abnormalities in skull development, and secondary craniosynostosis results from failure of brain growth. Evidence: TAS. Frequency: Occasional (HP:0040283). (ORPHA:363611)
- Mitral regurgitation (HP:0001653): An abnormality of the mitral valve characterized by insufficiency or incompetence of the mitral valve resulting in retrograde leaking of blood through the mitral valve upon ventricular contraction. Evidence: TAS. Frequency: Occasional (HP:0040283). (ORPHA:363611)
- Coarctation of aorta (HP:0001680): Coarctation of the aorta is a narrowing or constriction of a segment of the aorta. Evidence: TAS. Frequency: Occasional (HP:0040283). (ORPHA:363611)
- Phimosis (HP:0001741): The male foreskin cannot be fully retracted from the head of the penis. Evidence: TAS. Frequency: Occasional (HP:0040283). (ORPHA:363611)
- Short columella (HP:0002000): Reduced distance from the anterior border of the naris to the subnasale. Evidence: TAS. Frequency: Occasional (HP:0040283). (ORPHA:363611)
- Gastroesophageal reflux (HP:0002020): A condition in which the stomach contents leak backwards from the stomach into the esophagus through the lower esophageal sphincter. Evidence: TAS. Frequency: Occasional (HP:0040283). (ORPHA:363611)
- Pulmonary arterial hypertension (HP:0002092): Pulmonary hypertension is defined mean pulmonary artery pressure of 25mmHg or more and pulmonary capillary wedge pressure of 15mmHg or less when measured by right heart catheterisation at rest and in a supine position. Evidence: TAS. Frequency: Occasional (HP:0040283). (ORPHA:363611)
- Sleep disturbance (HP:0002360): An abnormal pattern in the quality, quantity, or characteristics of sleep. Evidence: TAS. Frequency: Occasional (HP:0040283). (ORPHA:363611)
- Highly arched eyebrow (HP:0002553): Increased height of the central portion of the eyebrow, forming a crescent, semicircular, or inverted U shape. Evidence: TAS. Frequency: Occasional (HP:0040283). (ORPHA:363611)
- Recurrent lower respiratory tract infections (HP:0002783): An increased susceptibility to lower respiratory tract infections as manifested by a history of recurrent lower respiratory tract infections. Evidence: TAS. Frequency: Occasional (HP:0040283). (ORPHA:363611)
- Short nose (HP:0003196): Distance from nasion to subnasale more than two standard deviations below the mean, or alternatively, an apparently decreased length from the nasal root to the nasal tip. Evidence: TAS. Frequency: Occasional (HP:0040283). (ORPHA:363611)
- 2-3 toe syndactyly (HP:0004691): Syndactyly with fusion of toes two and three. Evidence: TAS. Frequency: Occasional (HP:0040283). (ORPHA:363611)
- Chronic lung disease (HP:0006528): According to the definitions of the American and British Thoracic Societies, including pulmonary functional tests, X-rays, and CT scans for items such as fibrosis, bronchiectasis, bullae, emphysema, nodular or lymphomatous abnormalities. Evidence: TAS. Frequency: Occasional (HP:0040283). (ORPHA:363611)
- Prolonged neonatal jaundice (HP:0006579): Neonatal jaundice refers to a yellowing of the skin and other tissues of a newborn infant as a result of increased concentrations of bilirubin in the blood. Neonatal jaundice affects over half of all newborns to some extent in the first week of life. Prolonged neonatal jaundice is said to be present if the jaundice persists for longer than 14 days in term infants and 21 days in preterm infants. Evidence: TAS. Frequency: Occasional (HP:0040283). (ORPHA:363611)
- Joint contracture of the 5th finger (HP:0009183): Chronic loss of joint motion in the 5th finger due to structural changes in non-bony tissue. The term camptodactyly of the 5th finger is used if the distal and/or proximal interphalangeal joints are affected. Evidence: TAS. Frequency: Occasional (HP:0040283). (ORPHA:363611)
- Nasogastric tube feeding in infancy (HP:0011470): Feeding problem necessitating nasogastric tube feeding. Evidence: TAS. Frequency: Occasional (HP:0040283). (ORPHA:363611)
- Midface retrusion (HP:0011800): Posterior positions and/or vertical shortening of the infraorbital and perialar regions, or increased concavity of the face and/or reduced nasolabial angle. Evidence: TAS. Frequency: Occasional (HP:0040283). (ORPHA:363611)
- Fetal distress (HP:0025116): An intrauterine state characterized by suboptimal values in the fetal heart rate, oxygenation of fetal blood, or other parameters indicative of compromise of the fetus. Signs of fetal distress include repetitive variable decelerations, fetal tachycardia or bradycardia, late decelerations, or low biophysical profile. Evidence: TAS. Frequency: Occasional (HP:0040283). (ORPHA:363611)
- Abnormal temper tantrums (HP:0025160): Temper tantrums are brief episodes of extreme, unpleasant, and sometimes aggressive behaviors in response to frustration or anger, which are a normal part of development in toddlers. Temper tantrums that occur more frequently in a given time and/or are more severe in symptomatology and/or longer in duration and/or inappropriate for the given age compared to a temper tantrum that naturally occurs as a part of the developmental process are classified as abnormal temper tantrums. Evidence: TAS. Frequency: Occasional (HP:0040283). (ORPHA:363611)
- Pulmonary hemorrhage (HP:0040223): Pulmonary hemorrhage is a bleeding within the lungs. Older children and adults may spit blood or bloody sputum. Neonates, infants and young children usually do not spit up blood. Anemia, pulmonary infiltrates, increasingling bloody return on BAL and the presence of hemosiderin-laden macrophages in broncho-alveolar lavage (BAL) fluid or lung biopsy can diagnose lung bleeding. Alveolar macrophages contain phagocytosed red blood cells and stain positive for hemosiderin, a product of hemoglobin degradation, after about 48-72 hours following pulmonary hemorraghe. Previous or recurrent bleeding can thus be distinguished from fresh events. A differentiation into local or diffuse is of importance. Also differentiate if pulmonary hemorrhage is due to a primary lung disorder or a manifestation of a systemic disease. Evidence: TAS. Frequency: Occasional (HP:0040283). (ORPHA:363611)
- Sepsis (HP:0100806): Sepsis is defined as life-threatening organ dysfunction caused by a dysregulated host response to infection. Evidence: TAS. Frequency: Occasional (HP:0040283). (ORPHA:363611)
These phenotypes are associated with the disease CTCF-related neurodevelopmental disorder (ORPHA:363611).